- Thin upper lip vermilion (HP:0000219): Height of the vermilion of the upper lip in the midline more than 2 SD below the mean. Alternatively, an apparently reduced height of the vermilion of the upper lip in the frontal view (subjective). Evidence: TAS. Frequency: Frequent (HP:0040282). (ORPHA:401935)
- Hypertelorism (HP:0000316): Interpupillary distance more than 2 SD above the mean (alternatively, the appearance of an increased interpupillary distance or widely spaced eyes). Evidence: TAS. Frequency: Frequent (HP:0040282). (ORPHA:401935)
- Downslanted palpebral fissures (HP:0000494): The palpebral fissure inclination is more than two standard deviations below the mean. Evidence: TAS. Frequency: Frequent (HP:0040282). (ORPHA:401935)
- Brachydactyly (HP:0001156): Digits that appear disproportionately short compared to the hand/foot. The word brachydactyly is used here to describe a series distinct patterns of shortened digits (brachydactyly types A-E). This is the sense used here. Evidence: TAS. Frequency: Frequent (HP:0040282). (ORPHA:401935)
- Mild intellectual disability (HP:0001256): Mild intellectual disability (ID) is defined as a type of ID characterized by mildly sub-average adaptive functioning and intellectual functioning, with an intelligence quotient (IQ) the range of 50-69. Evidence: TAS. Frequency: Frequent (HP:0040282). (ORPHA:401935)
- Joint hypermobility (HP:0001382): The capability that a joint (or a group of joints) has to move, passively and/or actively, beyond normal limits along physiological axes. Evidence: TAS. Frequency: Frequent (HP:0040282). (ORPHA:401935)
- Abnormal heart morphology (HP:0001627): Any structural anomaly of the heart. Evidence: TAS. Frequency: Frequent (HP:0040282). (ORPHA:401935)
- Short thumb (HP:0009778): Hypoplasia (congenital reduction in size) of the thumb. Evidence: TAS. Frequency: Frequent (HP:0040282). (ORPHA:401935)
- Cryptorchidism (HP:0000028): Testis in inguinal canal. That is, absence of one or both testes from the scrotum owing to failure of the testis or testes to descend through the inguinal canal to the scrotum. Evidence: TAS. Frequency: Occasional (HP:0040283). (ORPHA:401935)
- Ectopic kidney (HP:0000086): A developmental defect in which a kidney is located in an abnormal anatomic position. Evidence: TAS. Frequency: Occasional (HP:0040283). (ORPHA:401935)
- Smooth philtrum (HP:0000319): Flat skin surface, with no ridge formation in the central region of the upper lip between the nasal base and upper vermilion border. Evidence: TAS. Frequency: Occasional (HP:0040283). (ORPHA:401935)
- Long philtrum (HP:0000343): Distance between nasal base and midline upper lip vermilion border more than 2 SD above the mean. Alternatively, an apparently increased distance between nasal base and midline upper lip vermilion border. Evidence: TAS. Frequency: Occasional (HP:0040283). (ORPHA:401935)
- Prominent nasal bridge (HP:0000426): Anterior positioning of the nasal root in comparison to the usual positioning for age. Evidence: TAS. Frequency: Occasional (HP:0040283). (ORPHA:401935)
- Wide nasal bridge (HP:0000431): Increased breadth of the nasal bridge (and with it, the nasal root). Evidence: TAS. Frequency: Occasional (HP:0040283). (ORPHA:401935)
- Synophrys (HP:0000664): Meeting of the medial eyebrows in the midline. Evidence: TAS. Frequency: Occasional (HP:0040283). (ORPHA:401935)
- Ventricular septal defect (HP:0001629): A hole between the two bottom chambers (ventricles) of the heart. The defect is centered around the most superior aspect of the ventricular septum. Evidence: TAS. Frequency: Occasional (HP:0040283). (ORPHA:401935)
- Atrial septal defect (HP:0001631): Atrial septal defect (ASD) is a congenital abnormality of the interatrial septum that enables blood flow between the left and right atria via the interatrial septum. Evidence: TAS. Frequency: Occasional (HP:0040283). (ORPHA:401935)
- Truncus arteriosus (HP:0001660): A single arterial trunk arises from the cardiac mass. The pulmonary arteries, aorta and coronary arteries arise from this single trunk with no evidence of another outflow tract. Evidence: TAS. Frequency: Occasional (HP:0040283). (ORPHA:401935)
- Intestinal malrotation (HP:0002566): An abnormality of the intestinal rotation and fixation that normally occurs during the development of the gut. This can lead to volvulus, or twisting of the intestine that causes obstruction and necrosis. Evidence: TAS. Frequency: Occasional (HP:0040283). (ORPHA:401935)
- Dislocated radial head (HP:0003083): A dislocation of the head of the radius from its socket in the elbow joint. Evidence: TAS. Frequency: Occasional (HP:0040283). (ORPHA:401935)
- Short nose (HP:0003196): Distance from nasion to subnasale more than two standard deviations below the mean, or alternatively, an apparently decreased length from the nasal root to the nasal tip. Evidence: TAS. Frequency: Occasional (HP:0040283). (ORPHA:401935)
- Pulmonary artery atresia (HP:0004935): A congenital anomaly with a narrowing or complete absence of the opening between the right ventricle and the pulmonary artery. Evidence: TAS. Frequency: Occasional (HP:0040283). (ORPHA:401935)
- Limited elbow extension and supination (HP:0005852). Evidence: TAS. Frequency: Occasional (HP:0040283). (ORPHA:401935)
- Midface retrusion (HP:0011800): Posterior positions and/or vertical shortening of the infraorbital and perialar regions, or increased concavity of the face and/or reduced nasolabial angle. Evidence: TAS. Frequency: Occasional (HP:0040283). (ORPHA:401935)
These phenotypes are associated with the disease 14q24.1q24.3 microdeletion syndrome (ORPHA:401935).